- Metaphase I oocyte maturation arrest (HP:0031516): Failure of oocytes to proceed through the stages of meiosis with stoppage at the first metaphase stage. Evidence: PCS. Frequency: 2/2. (PMID:28965844)
- Female infertility (HP:0008222). Evidence: PCS. Frequency: 4/4. (PMID:28965844)
- Young adult onset (HP:0011462): Onset of disease at the age of between 16 and 40 years. Evidence: PCS. Frequency: 4/4. (PMID:28965844)
- Autosomal recessive inheritance (HP:0000007): A mode of inheritance that is observed for traits related to a gene encoded on one of the autosomes (i.e., the human chromosomes 1-22) in which a trait manifests in individuals with two pathogenic alleles, either homozygotes (two copies of the same mutant allele) or compound heterozygotes (whereby each copy of a gene has a distinct mutant allele). Evidence: PCS. (PMID:28965844)
These phenotypes are associated with the disease oocyte maturation defect 4 (OMIM:617743).